- Overfolded helix (HP:0000396): A condition in which the helix is folded over to a greater degree than normal. That is, excessive curling of the helix edge, whereby the free edge is parallel to the plane of the ear. Evidence: TAS. Frequency: Frequent (HP:0040282). (ORPHA:324410)
- Macrotia (HP:0000400): Median longitudinal ear length greater than two standard deviations above the mean and median ear width greater than two standard deviations above the mean (objective); or, apparent increase in length and width of the pinna (subjective). Evidence: TAS. Frequency: Frequent (HP:0040282). (ORPHA:324410)
- Abnormal thumb morphology (HP:0001172): An abnormal structure of the first digit of the hand. Evidence: TAS. Frequency: Frequent (HP:0040282). (ORPHA:324410)
- Seizure (HP:0001250): A seizure is an intermittent abnormality of nervous system physiology characterized by a transient occurrence of signs and/or symptoms due to abnormal excessive or synchronous neuronal activity in the brain. Evidence: TAS. Frequency: Frequent (HP:0040282). (ORPHA:324410)
- Global developmental delay (HP:0001263): A delay in the achievement of motor or mental milestones in the domains of development of a child, including motor skills, speech and language, cognitive skills, and social and emotional skills. This term should only be used to describe children younger than five years of age. Evidence: TAS. Frequency: Frequent (HP:0040282). (ORPHA:324410)
- Absent speech (HP:0001344): Complete lack of development of speech and language abilities. Evidence: TAS. Frequency: Frequent (HP:0040282). (ORPHA:324410)
- Congestive heart failure (HP:0001635): The presence of an abnormality of cardiac function that is responsible for the failure of the heart to pump blood at a rate that is commensurate with the needs of the tissues or a state in which abnormally elevated filling pressures are required for the heart to do so. Heart failure is frequently related to a defect in myocardial contraction. Evidence: TAS. Frequency: Frequent (HP:0040282). (ORPHA:324410)
- Cardiomegaly (HP:0001640): Increased size of the heart, clinically defined as an increased transverse diameter of the cardiac silhouette that is greater than or equal to 50% of the transverse diameter of the chest (increased cardiothoracic ratio) on a posterior-anterior projection of a chest radiograph or a computed tomography. Evidence: TAS. Frequency: Frequent (HP:0040282). (ORPHA:324410)
- Profound intellectual disability (HP:0002187): Profound intellectual disability (ID) is defined as a type of ID characterized by profoundly sub-average adaptive functioning and intellectual functioning, with an intelligence quotient (IQ) below 20. Evidence: TAS. Frequency: Frequent (HP:0040282). (ORPHA:324410)
- Contractures of the large joints (HP:0005781). Evidence: TAS. Frequency: Frequent (HP:0040282). (ORPHA:324410)
- Abnormal atrioventricular valve morphology (HP:0006705): An abnormality of an atrioventricular valve. Evidence: TAS. Frequency: Frequent (HP:0040282). (ORPHA:324410)
- Macroorchidism (HP:0000053): The presence of abnormally large testes. Evidence: TAS. Frequency: Occasional (HP:0040283). (ORPHA:324410)
- Everted lower lip vermilion (HP:0000232): An abnormal configuration of the lower lip such that it is turned outward i.e., everted, with the Inner aspect of the lower lip vermilion (normally opposing the teeth) being visible in a frontal view. Evidence: TAS. Frequency: Occasional (HP:0040283). (ORPHA:324410)
- Coarse facial features (HP:0000280): Absence of fine and sharp appearance of brows, nose, lips, mouth, and chin, usually because of rounded and heavy features or thickened skin with or without thickening of subcutaneous and bony tissues. Evidence: TAS. Frequency: Occasional (HP:0040283). (ORPHA:324410)
- Mandibular prognathia (HP:0000303): Abnormal prominence of the chin related to increased length of the mandible. Evidence: TAS. Frequency: Occasional (HP:0040283). (ORPHA:324410)
- Smooth philtrum (HP:0000319): Flat skin surface, with no ridge formation in the central region of the upper lip between the nasal base and upper vermilion border. Evidence: TAS. Frequency: Occasional (HP:0040283). (ORPHA:324410)
- Bulbous nose (HP:0000414): Increased volume and globular shape of the anteroinferior aspect of the nose. Evidence: TAS. Frequency: Occasional (HP:0040283). (ORPHA:324410)
- Prominent nasal bridge (HP:0000426): Anterior positioning of the nasal root in comparison to the usual positioning for age. Evidence: TAS. Frequency: Occasional (HP:0040283). (ORPHA:324410)
- Mitral valve prolapse (HP:0001634): One or both of the leaflets (cusps) of the mitral valve bulges back into the left atrium upon contraction of the left ventricle. Evidence: TAS. Frequency: Occasional (HP:0040283). (ORPHA:324410)
- Aortic valve stenosis (HP:0001650): The presence of a stenosis (narrowing) of the aortic valve. Evidence: TAS. Frequency: Occasional (HP:0040283). (ORPHA:324410)
- Mitral regurgitation (HP:0001653): An abnormality of the mitral valve characterized by insufficiency or incompetence of the mitral valve resulting in retrograde leaking of blood through the mitral valve upon ventricular contraction. Evidence: TAS. Frequency: Occasional (HP:0040283). (ORPHA:324410)
- Poor speech (HP:0002465). Evidence: TAS. Frequency: Occasional (HP:0040283). (ORPHA:324410)
- Spastic tetraplegia (HP:0002510): Spastic paralysis affecting all four limbs. Evidence: TAS. Frequency: Occasional (HP:0040283). (ORPHA:324410)
- Inability to walk (HP:0002540): Incapability to ambulate. Evidence: TAS. Frequency: Occasional (HP:0040283). (ORPHA:324410)
- Kyphoscoliosis (HP:0002751): An abnormal curvature of the spine in both a coronal (lateral) and sagittal (back-to-front) plane. Evidence: TAS. Frequency: Occasional (HP:0040283). (ORPHA:324410)
- Steppage gait (HP:0003376): An abnormal gait pattern that arises from weakness of the pretibial and peroneal muscles due to a lower motor neuron lesion. Affected patients have footdrop and are unable to dorsiflex and evert the foot. The leg is lifted high on walking so that the toes clear the ground, and there may be a slapping noise when the foot strikes the ground again. Evidence: TAS. Frequency: Occasional (HP:0040283). (ORPHA:324410)
- Atrial flutter (HP:0004749): A type of atrial arrhythmia characterized by atrial rates of between 240 and 400 beats per minute and some degree of atrioventricular node conduction block. Typically, the ventricular rate is half the atrial rate. In the EKG; atrial flutter waves are observed as sawtooth-like atrial activity. Pathophysiologically, atrial flutter is a form of atrial reentry in which there is a premature electrical impulse creates a self-propagating circuit. Evidence: TAS. Frequency: Occasional (HP:0040283). (ORPHA:324410)
- Tricuspid regurgitation (HP:0005180): Failure of the tricuspid valve to close sufficiently upon contraction of the right ventricle, causing blood to regurgitate (flow backward) into the right atrium. Evidence: TAS. Frequency: Occasional (HP:0040283). (ORPHA:324410)
- Depressed nasal bridge (HP:0005280): Posterior positioning of the nasal root in relation to the overall facial profile for age. Evidence: TAS. Frequency: Occasional (HP:0040283). (ORPHA:324410)
- Protruding tongue (HP:0010808): Tongue extending beyond the alveolar ridges or teeth at rest. Evidence: TAS. Frequency: Occasional (HP:0040283). (ORPHA:324410)
These phenotypes are associated with the disease X-linked intellectual disability-cardiomegaly-congestive heart failure syndrome (ORPHA:324410).